- Juvenile onset (HP:0003621): Onset of signs or symptoms of disease between the age of 5 and 15 years. Evidence: PCS. (PMID:29961571)
- Progressive sensorineural hearing impairment (HP:0000408): A progressive form of sensorineural hearing impairment. Evidence: PCS. (PMID:29961571)
- Childhood onset (HP:0011463): Onset of disease at the age of between 1 and 5 years. Evidence: PCS. (PMID:29961571)
- Autosomal recessive inheritance (HP:0000007): A mode of inheritance that is observed for traits related to a gene encoded on one of the autosomes (i.e., the human chromosomes 1-22) in which a trait manifests in individuals with two pathogenic alleles, either homozygotes (two copies of the same mutant allele) or compound heterozygotes (whereby each copy of a gene has a distinct mutant allele). Evidence: PCS. (PMID:29961571)
These phenotypes are associated with the disease hearing loss, autosomal recessive 111 (OMIM:618145).